- Sparse eyelashes (HP:0000653): Decreased density/number of eyelashes. Evidence: TAS. Frequency: Very frequent (HP:0040281). (ORPHA:55654)
- Alopecia (HP:0001596): A noncongenital process of hair loss, which may progress to partial or complete baldness. Evidence: TAS. Frequency: Very frequent (HP:0040281). (ORPHA:55654)
- Sparse scalp hair (HP:0002209): Decreased number of hairs per unit area of skin of the scalp. Evidence: TAS. Frequency: Very frequent (HP:0040281). (ORPHA:55654)
- Sparse body hair (HP:0002231): Sparseness of the body hair. Evidence: TAS. Frequency: Very frequent (HP:0040281). (ORPHA:55654)
- Sparse eyebrow (HP:0045075): Decreased density/number of eyebrow hairs. Evidence: TAS. Frequency: Very frequent (HP:0040281). (ORPHA:55654)
- Sparse hair (HP:0008070): Reduced density of hairs. Evidence: TAS. Frequency: Frequent (HP:0040282). (ORPHA:55654)
These phenotypes are associated with the disease Hypotrichosis simplex (ORPHA:55654).